Phenotypes associated with the disease Benign schwannoma (ORPHA:252164):
- Abnormal cranial nerve morphology (HP:0001291): Structural abnormality affecting one or more of the cranial nerves, which emerge directly from the brain stem. Evidence: TAS. Frequency: Very frequent (HP:0040281). (ORPHA:252164)
- Vestibular schwannoma (HP:0009588): A vestibular schwannoma (also known as acoustic neuroma, acoustic neurinoma, or acoustic neurilemoma) is a benign, usually slow-growing tumor that develops from the VIIIth cranial nerve supplying the inner ear. Evidence: TAS. Frequency: Very frequent (HP:0040281). (ORPHA:252164)
- Peripheral schwannoma (HP:0009593): The presence of a peripheral schwannoma. Evidence: TAS. Frequency: Very frequent (HP:0040281). (ORPHA:252164)
- Abnormal temporal bone morphology (HP:0009911): Abnormality of the temporal bone of the skull, which is situated at the sides and base of the skull roughly underlying the region of the face known as the temple. Evidence: TAS. Frequency: Very frequent (HP:0040281). (ORPHA:252164)
- Abnormality of peripheral nervous system electrophysiology (HP:0030177): An abnormality of the function of the electrical signals with which peripheral nerve cells communicate with each other or with muscles. Evidence: TAS. Frequency: Very frequent (HP:0040281). (ORPHA:252164)
- Schwannoma (HP:0100008): A benign nerve sheath tumor composed of Schwann cells. Evidence: TAS. Frequency: Very frequent (HP:0040281). (ORPHA:252164)
- Scleral schwannoma (HP:0100011). Evidence: TAS. Frequency: Very frequent (HP:0040281). (ORPHA:252164)
- Hearing abnormality (HP:0000364): An abnormality of the sensory perception of sound. Evidence: TAS. Frequency: Frequent (HP:0040282). (ORPHA:252164)
- Vertigo (HP:0002321): An abnormal sensation of spinning while the body is actually stationary. Evidence: TAS. Frequency: Frequent (HP:0040282). (ORPHA:252164)
- Facial palsy (HP:0010628): Facial nerve palsy is a dysfunction of cranial nerve VII (the facial nerve) that results in inability to control facial muscles on the affected side with weakness of the muscles of facial expression and eye closure. This can either be present in unilateral or bilateral form. Evidence: TAS. Frequency: Frequent (HP:0040282). (ORPHA:252164)
- Allodynia (HP:0012533): Pain due to a stimulus that does not normally provoke pain. Evidence: TAS. Frequency: Frequent (HP:0040282). (ORPHA:252164)
- Abnormal parotid gland morphology (HP:0000197): Any abnormality of the parotid glands, which are the salivary glands that are located in the subcutaneous tissues of the face overlying the mandibular ramus and anterior and inferior to the external ear. Evidence: TAS. Frequency: Occasional (HP:0040283). (ORPHA:252164)
- Abnormality of the breast (HP:0000769): An abnormality of the breast. Evidence: TAS. Frequency: Occasional (HP:0040283). (ORPHA:252164)
- Abnormality of the adrenal glands (HP:0000834): Abnormality of the adrenal glands, i.e., of the endocrine glands located at the top of the kindneys. Evidence: TAS. Frequency: Occasional (HP:0040283). (ORPHA:252164)
- Abnormality of the liver (HP:0001392): An abnormality of the liver. Evidence: TAS. Frequency: Occasional (HP:0040283). (ORPHA:252164)
- Abnormality of the larynx (HP:0001600): An abnormality of the larynx. Evidence: TAS. Frequency: Occasional (HP:0040283). (ORPHA:252164)
- Morphological central nervous system abnormality (HP:0002011): A structural abnormality of the central nervous system. Evidence: TAS. Frequency: Occasional (HP:0040283). (ORPHA:252164)
- Abnormal esophagus morphology (HP:0002031): A structural abnormality of the esophagus. Evidence: TAS. Frequency: Occasional (HP:0040283). (ORPHA:252164)
- Abnormal fibula morphology (HP:0002991): An anomaly of the calf bone (fibula), one of the two bones of the calf. Evidence: TAS. Frequency: Occasional (HP:0040283). (ORPHA:252164)
- Acute episodes of neuropathic symptoms (HP:0003489). Evidence: TAS. Frequency: Occasional (HP:0040283). (ORPHA:252164)
- Abnormality of the twelfth cranial nerve (HP:0010826): Abnormality of the twelfth cranial nerve. Evidence: TAS. Frequency: Occasional (HP:0040283). (ORPHA:252164)
- Pain (HP:0012531): An unpleasant sensory and emotional experience associated with actual or potential tissue damage, or described in terms of such damage. Evidence: TAS. Frequency: Occasional (HP:0040283). (ORPHA:252164)
- Nasal polyposis (HP:0100582): Polypoidal masses arising mainly from the mucous membranes of the nose and paranasal sinuses. They are freely movable and nontender overgrowths of the mucosa that frequently accompany allergic rhinitis. Evidence: TAS. Frequency: Occasional (HP:0040283). (ORPHA:252164)
- Intestinal polyposis (HP:0200008): The presence of multiple polyps in the intestine. Evidence: TAS. Frequency: Occasional (HP:0040283). (ORPHA:252164)
Not associated with this disease:
- Malignant peripheral nerve sheath tumor (HP:0100697): Malignant peripheral nerve sheath tumors (MPNSTs) are aggressive soft tissue sarcomas (STS) with nerve sheath differentiation and a tendency to metastasize. Evidence: TAS. (ORPHA:252164)